Phenotypes associated with the disease Schnyder corneal dystrophy (OMIM:121800):
- Corneal dystrophy (HP:0001131): The term corneal dystrophy embraces a heterogenous group of bilateral genetically determined non-inflammatory corneal diseases that are restricted to the cornea. Evidence: IEA. (OMIM:121800)
- Crystalline corneal dystrophy (HP:0007760). Evidence: IEA. (OMIM:121800)
- Autosomal dominant inheritance (HP:0000006): A mode of inheritance that is observed for traits related to a gene encoded on one of the autosomes (i.e., the human chromosomes 1-22) in which a trait manifests in heterozygotes. In the context of medical genetics, an autosomal dominant disorder is caused when a single copy of the mutant allele is present. Males and females are affected equally, and can both transmit the disorder with a risk of 50% for each child of inheriting the mutant allele. Evidence: IEA. (OMIM:121800)